- Sensorineural hearing impairment (HP:0000407): A type of hearing impairment in one or both ears related to an abnormal functionality of the cochlear nerve. Evidence: PCS. Onset: Juvenile onset (HP:0003621). (PMID:18279434)
- Autosomal dominant inheritance (HP:0000006): A mode of inheritance that is observed for traits related to a gene encoded on one of the autosomes (i.e., the human chromosomes 1-22) in which a trait manifests in heterozygotes. In the context of medical genetics, an autosomal dominant disorder is caused when a single copy of the mutant allele is present. Males and females are affected equally, and can both transmit the disorder with a risk of 50% for each child of inheriting the mutant allele. Evidence: PCS. (PMID:18279434)
These phenotypes are associated with the disease autosomal dominant nonsyndromic hearing loss 27 (OMIM:612431).